Phenotypes associated with the disease Congenital pulmonary airway malformation (ORPHA:2444):
- Polyhydramnios (HP:0001561): The presence of excess amniotic fluid in the uterus during pregnancy. Evidence: TAS. Frequency: Occasional (HP:0040283). (ORPHA:2444)
- Premature birth (HP:0001622): The birth of a baby of less than 37 weeks of gestational age. Evidence: TAS. Frequency: Occasional (HP:0040283). (ORPHA:2444)
- Abnormality of the respiratory system (HP:0002086): An abnormality of the respiratory system, which include the airways, lungs, and the respiratory muscles. Evidence: TAS. Frequency: Very frequent (HP:0040281). (ORPHA:2444)
- Respiratory insufficiency (HP:0002093). Evidence: TAS. Frequency: Occasional (HP:0040283). (ORPHA:2444)
- Abnormal pleura morphology (HP:0002103): An abnormality of the pulmonary pleura, the thin, transparent membrane which covers the lungs and lines the inside of the chest walls. Evidence: TAS. Frequency: Occasional (HP:0040283). (ORPHA:2444)